Phenotypes associated with the disease renal cysts and diabetes syndrome (DECIPHER:47):
- Diabetes mellitus (HP:0000819): A group of abnormalities characterized by hyperglycemia and glucose intolerance. Evidence: IEA. (DECIPHER:47)
- Abnormality of the liver (HP:0001392): An abnormality of the liver. Evidence: IEA. (DECIPHER:47)
- Multiple renal cysts (HP:0005562): The presence of many cysts in the kidney. Evidence: IEA. (DECIPHER:47)